- Uveal melanoma (HP:0007716): A malignant melanoma originating within the eye. The tumor originates from the melanocytes in the uvea (which comprises the iris, ciliary body, and choroid). Evidence: TAS. (OMIM:155720)
- Autosomal dominant inheritance (HP:0000006): A mode of inheritance that is observed for traits related to a gene encoded on one of the autosomes (i.e., the human chromosomes 1-22) in which a trait manifests in heterozygotes. In the context of medical genetics, an autosomal dominant disorder is caused when a single copy of the mutant allele is present. Males and females are affected equally, and can both transmit the disorder with a risk of 50% for each child of inheriting the mutant allele. Evidence: TAS. (OMIM:155720)
These phenotypes are associated with the disease uveal melanoma (OMIM:155720).